Phenotypes associated with the disease aminoacylase 1 deficiency (OMIM:609924):
- Bilateral tonic-clonic seizure (HP:0002069): A bilateral tonic-clonic seizure is a seizure defined by a tonic (bilateral increased tone, lasting seconds to minutes) and then a clonic (bilateral sustained rhythmic jerking) phase. Evidence: PCS. Frequency: 1/1. (PMID:16274666)
- Acute encephalopathy (HP:0006846). Evidence: PCS. Frequency: 1/1. (PMID:16274666)
- Cerebral atrophy (HP:0002059): Atrophy (wasting, decrease in size of cells or tissue) affecting the cerebrum. Evidence: IEA. (OMIM:609924)
- Delayed CNS myelination (HP:0002188): Delayed myelination in the central nervous system. Evidence: IEA. (OMIM:609924)
- Wide nasal bridge (HP:0000431): Increased breadth of the nasal bridge (and with it, the nasal root). Evidence: IEA. (OMIM:609924)
- Bradycardia (HP:0001662): A slower than normal heart rate (in adults, slower than 60 beats per minute). Evidence: PCS. Frequency: 1/1. (PMID:16274666)
- Cerebellar atrophy (HP:0001272): Cerebellar atrophy is defined as a cerebellum with initially normal structures, in a posterior fossa with normal size, which displays enlarged fissures (interfolial spaces) in comparison to the foliae secondary to loss of tissue. Cerebellar atrophy implies irreversible loss of tissue and result from an ongoing progressive disease until a final stage is reached or a single injury, e.g. an intoxication or infectious event. Evidence: IEA. (OMIM:609924)
- Cerebral cortical atrophy (HP:0002120): Atrophy of the cortex of the cerebrum. Evidence: PCS. Frequency: 1/1. (PMID:16274666)
- Feeding difficulties (HP:0011968): Impaired ability to eat related to problems gathering food and getting ready to suck, chew, or swallow it. Evidence: PCS. Frequency: 1/1. (PMID:16274666)
- Seizure (HP:0001250): A seizure is an intermittent abnormality of nervous system physiology characterized by a transient occurrence of signs and/or symptoms due to abnormal excessive or synchronous neuronal activity in the brain. Evidence: IEA. (OMIM:609924)
- Global developmental delay (HP:0001263): A delay in the achievement of motor or mental milestones in the domains of development of a child, including motor skills, speech and language, cognitive skills, and social and emotional skills. This term should only be used to describe children younger than five years of age. Evidence: TAS. (OMIM:609924)
- Hypotonia (HP:0001252): Hypotonia is an abnormally low muscle tone (the amount of tension or resistance to movement in a muscle). Even when relaxed, muscles have a continuous and passive partial contraction which provides some resistance to passive stretching. Hypotonia thus manifests as diminished resistance to passive stretching. Hypotonia is not the same as muscle weakness, although the two conditions can co-exist. Evidence: IEA. (OMIM:609924)
- Generalized hypotonia (HP:0001290): Generalized muscular hypotonia (abnormally low muscle tone). Evidence: PCS. Frequency: 1/1. (PMID:16274666)
- Sensorineural hearing impairment (HP:0000407): A type of hearing impairment in one or both ears related to an abnormal functionality of the cochlear nerve. Evidence: PCS. Frequency: 1/1. (PMID:16274666)
- Hypertelorism (HP:0000316): Interpupillary distance more than 2 SD above the mean (alternatively, the appearance of an increased interpupillary distance or widely spaced eyes). Evidence: IEA. (OMIM:609924)
- Autosomal recessive inheritance (HP:0000007): A mode of inheritance that is observed for traits related to a gene encoded on one of the autosomes (i.e., the human chromosomes 1-22) in which a trait manifests in individuals with two pathogenic alleles, either homozygotes (two copies of the same mutant allele) or compound heterozygotes (whereby each copy of a gene has a distinct mutant allele). Evidence: PCS. (PMID:16274666)
- Hyperactivity (HP:0000752): Hyperactivity is a condition characterized by constant and unusually high levels of activity, even in situations where it is deemed inappropriate. Evidence: IEA. (OMIM:609924)
- Muscle weakness (HP:0001324): Reduced strength of muscles. Evidence: IEA. (OMIM:609924)
- Breech presentation (HP:0001623): A position of the fetus at delivery in which the fetus enters the birth canal with the buttocks or feet first. Evidence: PCS. Frequency: 1/1. (PMID:16274666)
- Neonatal onset (HP:0003623): Onset of signs or symptoms of disease within the first 28 days of life. Evidence: PCS. Frequency: 1/1. (PMID:16274666)